- Intellectual disability (HP:0001249): The term intellectual disability or intellectual developmental disorder is used to describe significantly sub-average intellectual and adaptive functioning based on clinical assessment and as measured by individually administered, appropriately normed, standardized and validated tests of intellectual functioning and adaptive behavior, with onset during the developmental period from infancy through adolescence. Evidence: TAS. Frequency: Very frequent (HP:0040281). (ORPHA:261537)
- Absent speech (HP:0001344): Complete lack of development of speech and language abilities. Evidence: TAS. Frequency: Very frequent (HP:0040281). (ORPHA:261537)
- Abnormal facial shape (HP:0001999): An abnormal morphology (form) of the face or its components. Evidence: TAS. Frequency: Very frequent (HP:0040281). (ORPHA:261537)
- Expressive language delay (HP:0002474): A delay in the acquisition of the ability to use language to communicate needs, wishes, or thoughts. Evidence: TAS. Frequency: Very frequent (HP:0040281). (ORPHA:261537)
- Happy demeanor (HP:0040082): A conspicuously happy disposition, characterized by frequent smiling and laughing, which may be contextually inappropriate or unrelated to the situation. Evidence: TAS. Frequency: Very frequent (HP:0040281). (ORPHA:261537)
- Urinary incontinence (HP:0000020): Loss of the ability to control the urinary bladder leading to involuntary urination. Evidence: TAS. Frequency: Frequent (HP:0040282). (ORPHA:261537)
- Cryptorchidism (HP:0000028): Testis in inguinal canal. That is, absence of one or both testes from the scrotum owing to failure of the testis or testes to descend through the inguinal canal to the scrotum. Evidence: TAS. Frequency: Frequent (HP:0040282). (ORPHA:261537)
- Hypospadias (HP:0000047): Abnormal position of urethral meatus on the ventral penile shaft (underside) characterized by displacement of the urethral meatus from the tip of the glans penis to the ventral surface of the penis, scrotum, or perineum. Evidence: TAS. Frequency: Frequent (HP:0040282). (ORPHA:261537)
- Abnormality of the genitourinary system (HP:0000119): The presence of any abnormality of the genitourinary system. Evidence: TAS. Frequency: Frequent (HP:0040282). (ORPHA:261537)
- Thick lower lip vermilion (HP:0000179): Increased thickness of the lower lip, leading to a prominent appearance of the lower lip. The height of the vermilion of the lower lip in the midline is more than 2 SD above the mean. Alternatively, an apparently increased height of the vermilion of the lower lip in the frontal view (subjective). Evidence: TAS. Frequency: Frequent (HP:0040282). (ORPHA:261537)
- Open mouth (HP:0000194): A facial appearance characterized by a permanently or nearly permanently opened mouth. Evidence: TAS. Frequency: Frequent (HP:0040282). (ORPHA:261537)
- Mandibular prognathia (HP:0000303): Abnormal prominence of the chin related to increased length of the mandible. Evidence: TAS. Frequency: Frequent (HP:0040282). (ORPHA:261537)
- Pointed chin (HP:0000307): A marked tapering of the lower face to the chin. Evidence: TAS. Frequency: Frequent (HP:0040282). (ORPHA:261537)
- Short philtrum (HP:0000322): Distance between nasal base and midline upper lip vermilion border more than 2 SD below the mean. Alternatively, an apparently decreased distance between nasal base and midline upper lip vermilion border. Evidence: TAS. Frequency: Frequent (HP:0040282). (ORPHA:261537)
- Posteriorly rotated ears (HP:0000358): A type of abnormal location of the ears in which the position of the ears is characterized by posterior rotation (the superior part of the ears is rotated towards the back of the head, and the inferior part of the ears towards the front). Evidence: TAS. Frequency: Frequent (HP:0040282). (ORPHA:261537)
- Recurrent otitis media (HP:0000403): Increased susceptibility to otitis media, as manifested by recurrent episodes of otitis media. Evidence: TAS. Frequency: Frequent (HP:0040282). (ORPHA:261537)
- Wide nasal bridge (HP:0000431): Increased breadth of the nasal bridge (and with it, the nasal root). Evidence: TAS. Frequency: Frequent (HP:0040282). (ORPHA:261537)
- Depressed nasal tip (HP:0000437): Decreased distance from the nasal tip to the nasal base. Evidence: TAS. Frequency: Frequent (HP:0040282). (ORPHA:261537)
- Convex nasal ridge (HP:0000444): Nasal ridge curving anteriorly to an imaginary line that connects the nasal root and tip. The nose appears often also prominent, and the columella low. Evidence: TAS. Frequency: Frequent (HP:0040282). (ORPHA:261537)
- Deeply set eye (HP:0000490): An eye that is more deeply recessed into the plane of the face than is typical. Evidence: TAS. Frequency: Frequent (HP:0040282). (ORPHA:261537)
- Telecanthus (HP:0000506): Distance between the inner canthi more than two standard deviations above the mean (objective); or, apparently increased distance between the inner canthi. Evidence: TAS. Frequency: Frequent (HP:0040282). (ORPHA:261537)
- Motor stereotypy (HP:0000733): Use of the same abnormal action in response to certain triggers or at random. They may be used as a way to regulate one's internal state but must otherwise have no apparent functional purpose. Evidence: TAS. Frequency: Frequent (HP:0040282). (ORPHA:261537)
- Seizure (HP:0001250): A seizure is an intermittent abnormality of nervous system physiology characterized by a transient occurrence of signs and/or symptoms due to abnormal excessive or synchronous neuronal activity in the brain. Evidence: TAS. Frequency: Frequent (HP:0040282). (ORPHA:261537)
- Spasticity (HP:0001257): A motor disorder characterized by a velocity-dependent increase in tonic stretch reflexes with increased muscle tone, exaggerated (hyperexcitable) tendon reflexes. Evidence: TAS. Frequency: Frequent (HP:0040282). (ORPHA:261537)
- Abnormal corpus callosum morphology (HP:0001273): Abnormality of the corpus callosum. Evidence: TAS. Frequency: Frequent (HP:0040282). (ORPHA:261537)
- Agenesis of corpus callosum (HP:0001274): Absence of the corpus callosum as a result of the failure of the corpus callosum to develop, which can be the result of a failure in any one of the multiple steps of callosal development including cellular proliferation and migration, axonal growth or glial patterning at the midline. Evidence: TAS. Frequency: Frequent (HP:0040282). (ORPHA:261537)
- Failure to thrive (HP:0001508): Failure to thrive (FTT) refers to a child whose physical growth is substantially below the norm. Evidence: TAS. Frequency: Frequent (HP:0040282). (ORPHA:261537)
- Abnormal heart morphology (HP:0001627): Any structural anomaly of the heart. Evidence: TAS. Frequency: Frequent (HP:0040282). (ORPHA:261537)
- Hypoplasia of the corpus callosum (HP:0002079): Underdevelopment of the corpus callosum. Evidence: TAS. Frequency: Frequent (HP:0040282). (ORPHA:261537)
- Broad-based gait (HP:0002136): An abnormal gait pattern in which persons stand and walk with their feet spaced widely apart. This is often a component of cerebellar ataxia. Evidence: TAS. Frequency: Frequent (HP:0040282). (ORPHA:261537)
- Aganglionic megacolon (HP:0002251): An abnormality resulting from a lack of intestinal ganglion cells (i.e., an aganglionic section of bowel) that results in bowel obstruction with enlargement of the colon. Evidence: TAS. Frequency: Frequent (HP:0040282). (ORPHA:261537)
- EEG abnormality (HP:0002353): Abnormality observed by electroencephalogram (EEG), which is used to record of the brain's spontaneous electrical activity from multiple electrodes placed on the scalp. Evidence: TAS. Frequency: Frequent (HP:0040282). (ORPHA:261537)
- Sleep disturbance (HP:0002360): An abnormal pattern in the quality, quantity, or characteristics of sleep. Evidence: TAS. Frequency: Frequent (HP:0040282). (ORPHA:261537)
- Bowel incontinence (HP:0002607): Involuntary fecal soiling in adults and children who have usually already been toilet trained. Evidence: TAS. Frequency: Frequent (HP:0040282). (ORPHA:261537)
- Short stature (HP:0004322): A height below that which is expected according to age and gender norms. Although there is no universally accepted definition of short stature, many refer to "short stature" as height more than 2 standard deviations below the mean for age and gender (or below the 3rd percentile for age and gender dependent norms). Evidence: TAS. Frequency: Frequent (HP:0040282). (ORPHA:261537)
- Secondary microcephaly (HP:0005484): Head circumference which falls below 2 standard deviations below the mean for age and gender because of insufficient head growth after birth. Evidence: TAS. Frequency: Frequent (HP:0040282). (ORPHA:261537)
- Lateral ventricle dilatation (HP:0006956). Evidence: TAS. Frequency: Frequent (HP:0040282). (ORPHA:261537)
- Poor fine motor coordination (HP:0007010): An abnormality of the ability (skills) to perform a precise movement of small muscles with the intent to perform a specific act. Fine motor skills are required to mediate movements of the wrists, hands, fingers, feet, and toes. Evidence: TAS. Frequency: Frequent (HP:0040282). (ORPHA:261537)
- Atypical absence seizure (HP:0007270): An atypical absence seizure is a type of generalized non-motor (absence) seizure characterized by interruption of ongoing activities and reduced responsiveness. In comparison to a typical absence seizure, changes in tone may be more pronounced, onset and/or cessation may be less abrupt, and the duration of the ictus and post-ictal recovery may be longer. Although not always available, an EEG often demonstrates slow (<3 Hz), irregular, generalized spike-wave activity. Evidence: TAS. Frequency: Frequent (HP:0040282). (ORPHA:261537)
- Focal-onset seizure (HP:0007359): A focal-onset seizure is a type of seizure originating within networks limited to one hemisphere. They may be discretely localized or more widely distributed, and may originate in subcortical structures. Evidence: TAS. Frequency: Frequent (HP:0040282). (ORPHA:261537)
- Floppy infant (HP:0008947): Floppiness/hypotonia is defined as reduced resistance to passive movement of joints. Physical examination of floppy/hypotonic infants shows head lag, lack of shoulder and elbow muscle contraction on traction response, inability to tighten the shoulder girdle muscles (or slipping through) when held under the axillae, scarf sign (when the arm is pulled to the opposite side, the arm wraps around the neck with the elbow crossing midline), hyperdorsiflexion of the feet, easy apposition of the thumb against the forearm, feet touching the cheek with ease and without discomfort, frog leg position, and inverted U sign on ventral suspension (head, arms, and legs hanging down without elbow or knee flexion and the trunk rounded in a dome shape). Evidence: TAS. Frequency: Frequent (HP:0040282). (ORPHA:261537)
- Low hanging columella (HP:0009765): Columella extending inferior to the level of the nasal base, when viewed from the side. Evidence: TAS. Frequency: Frequent (HP:0040282). (ORPHA:261537)
- Uplifted earlobe (HP:0009909): An abnormal orientation of the earlobes such that they point out- and upward. That is, the lateral surface of ear lobe faces superiorly. Evidence: TAS. Frequency: Frequent (HP:0040282). (ORPHA:261537)
- Broad eyebrow (HP:0011229): Regional increase in the width (height) of the eyebrow. Evidence: TAS. Frequency: Frequent (HP:0040282). (ORPHA:261537)
- Abnormal hippocampus morphology (HP:0025100): Any structural anomaly of the hippocampus,. Evidence: TAS. Frequency: Frequent (HP:0040282). (ORPHA:261537)
- Delayed ability to walk (HP:0031936): A failure to achieve the ability to walk at an appropriate developmental stage. Most children learn to walk in a series of stages, and learn to walk short distances independently between 12 and 15 months. Evidence: TAS. Frequency: Frequent (HP:0040282). (ORPHA:261537)
- Multicystic kidney dysplasia (HP:0000003): Multicystic dysplasia of the kidney is characterized by multiple cysts of varying size in the kidney and the absence of a normal pelvicaliceal system. The condition is associated with ureteral or ureteropelvic atresia, and the affected kidney is nonfunctional. Evidence: TAS. Frequency: Occasional (HP:0040283). (ORPHA:261537)
- Renal duplication (HP:0000075): A congenital anomaly of the urinary tract, in which the kidney is duplicated and is drained via two separate renal pelves and ureters. Evidence: TAS. Frequency: Occasional (HP:0040283). (ORPHA:261537)
- Vesicoureteral reflux (HP:0000076): Abnormal (retrograde) movement of urine from the bladder into ureters or kidneys related to inadequacy of the valvular mechanism at the ureterovesicular junction or other causes. Evidence: TAS. Frequency: Occasional (HP:0040283). (ORPHA:261537)
- Pelvic kidney (HP:0000125): A developmental defect in which a kidney is located in an abnormal anatomic position within the pelvis. Evidence: TAS. Frequency: Occasional (HP:0040283). (ORPHA:261537)
- Hydronephrosis (HP:0000126): Severe distention of the kidney with dilation of the renal pelvis and calices. Evidence: TAS. Frequency: Occasional (HP:0040283). (ORPHA:261537)
- Gingival overgrowth (HP:0000212): Hyperplasia of the gingiva (that is, a thickening of the soft tissue overlying the alveolar ridge. The degree of thickening ranges from involvement of the interdental papillae alone to gingival overgrowth covering the entire tooth crown. Evidence: TAS. Frequency: Occasional (HP:0040283). (ORPHA:261537)
- Hypertelorism (HP:0000316): Interpupillary distance more than 2 SD above the mean (alternatively, the appearance of an increased interpupillary distance or widely spaced eyes). Evidence: TAS. Frequency: Occasional (HP:0040283). (ORPHA:261537)
- Retinal coloboma (HP:0000480): A notch or cleft of the retina or choroid, located vertically below the optic disc. Evidence: TAS. Frequency: Occasional (HP:0040283). (ORPHA:261537)
- Astigmatism (HP:0000483): A type of refraction error associated with abnormal curvatures on the anterior and/or posterior surface of the cornea. Evidence: TAS. Frequency: Occasional (HP:0040283). (ORPHA:261537)
- Strabismus (HP:0000486): A misalignment of the eyes so that the visual axes deviate from bifoveal fixation. The classification of strabismus may be based on a number of features including the relative position of the eyes, whether the deviation is latent or manifest, intermittent or constant, concomitant or otherwise and according to the age of onset and the relevance of any associated refractive error. Evidence: TAS. Frequency: Occasional (HP:0040283). (ORPHA:261537)
- Ptosis (HP:0000508): The upper eyelid margin is positioned 3 mm or more lower than usual and covers the superior portion of the iris (objective); or, the upper lid margin obscures at least part of the pupil (subjective). Evidence: TAS. Frequency: Occasional (HP:0040283). (ORPHA:261537)
- Cataract (HP:0000518): A cataract is an opacity or clouding that develops in the crystalline lens of the eye or in its capsule. Evidence: TAS. Frequency: Occasional (HP:0040283). (ORPHA:261537)
- Myopia (HP:0000545): An abnormality of refraction characterized by the ability to see objects nearby clearly, while objects in the distance appear blurry. Evidence: TAS. Frequency: Occasional (HP:0040283). (ORPHA:261537)
- Microphthalmia (HP:0000568): A developmental anomaly characterized by abnormal smallness of one or both eyes. Evidence: TAS. Frequency: Occasional (HP:0040283). (ORPHA:261537)
- Iris coloboma (HP:0000612): A coloboma of the iris. Evidence: TAS. Frequency: Occasional (HP:0040283). (ORPHA:261537)
- Dental crowding (HP:0000678): Changes in alignment of teeth in the dental arch. Evidence: TAS. Frequency: Occasional (HP:0040283). (ORPHA:261537)
- Delayed eruption of teeth (HP:0000684): Delayed tooth eruption, which can be defined as tooth eruption more than 2 SD beyond the mean eruption age. Evidence: TAS. Frequency: Occasional (HP:0040283). (ORPHA:261537)
- Tooth malposition (HP:0000692): Abnormal alignment, positioning, or spacing of the teeth, i.e., misaligned teeth. Evidence: TAS. Frequency: Occasional (HP:0040283). (ORPHA:261537)
- Pectus excavatum (HP:0000767): A defect of the chest wall characterized by a depression of the sternum, giving the chest ("pectus") a caved-in ("excavatum") appearance. Evidence: TAS. Frequency: Occasional (HP:0040283). (ORPHA:261537)
- Pectus carinatum (HP:0000768): A deformity of the chest caused by overgrowth of the ribs and characterized by protrusion of the sternum. Evidence: TAS. Frequency: Occasional (HP:0040283). (ORPHA:261537)
- Abnormal posterior cranial fossa morphology (HP:0000932): An abnormality of the fossa cranii posterior (the posterior fossa), which is made up primarily of the occipital bone and which surrounds to the foramen magnum. Evidence: TAS. Frequency: Occasional (HP:0040283). (ORPHA:261537)
- Syndactyly (HP:0001159): Webbing or fusion of the fingers or toes, involving soft parts only or including bone structure. Bony fusions are referred to as "bony" syndactyly if the fusion occurs in a radio-ulnar axis. Fusions of bones of the fingers or toes in a proximo-distal axis are referred to as "symphalangism". Evidence: TAS. Frequency: Occasional (HP:0040283). (ORPHA:261537)
- Arachnodactyly (HP:0001166): Abnormally long and slender fingers (spider fingers). Evidence: TAS. Frequency: Occasional (HP:0040283). (ORPHA:261537)
- Adducted thumb (HP:0001181): In the resting position, the tip of the thumb is on, or near, the palm, close to the base of the fourth or fifth finger. Evidence: TAS. Frequency: Occasional (HP:0040283). (ORPHA:261537)
- Flexion contracture (HP:0001371): A flexion contracture is a bent (flexed) joint that cannot be straightened actively or passively. It is thus a chronic loss of joint motion due to structural changes in muscle, tendons, ligaments, or skin that prevents normal movement of joints. Evidence: TAS. Frequency: Occasional (HP:0040283). (ORPHA:261537)
- Axenfeld anomaly (HP:0001492): Axenfeld's anomaly is a bilateral disorder characterized by a prominent, anteriorly displaced Schwalbe's line (posterior embryotoxon) and peripheral iris strands which span the anterior chamber angle to attach to Schwalbe's line. Evidence: TAS. Frequency: Occasional (HP:0040283). (ORPHA:261537)
- Tetralogy of Fallot (HP:0001636): A congenital cardiac malformation comprising pulmonary stenosis, overriding aorta, ventricular septum defect, and right ventricular hypertrophy. The diagnosis of TOF is made if at least three of the four above mentioned features are present. Evidence: TAS. Frequency: Occasional (HP:0040283). (ORPHA:261537)
- Abnormal pulmonary valve morphology (HP:0001641): Any structural abnormality of the pulmonary valve. Evidence: TAS. Frequency: Occasional (HP:0040283). (ORPHA:261537)
- Pulmonic stenosis (HP:0001642): A narrowing of the right ventricular outflow tract that can occur at the pulmonary valve (valvular stenosis), below the pulmonary valve (infundibular stenosis), or above the pulmonary valve (supravalvar stenosis). Evidence: TAS. Frequency: Occasional (HP:0040283). (ORPHA:261537)
- Bicuspid aortic valve (HP:0001647): The presence of an aortic valve with two instead of the normal three cusps (flaps). Bicuspid aortic valvue is a malformation of a commissure (small space between the attachment of each cusp to the aortic wall) and the adjacent parts of the two corresponding cusps forming a raphe (the fused area of the two underdeveloped cusps turning into a malformed commissure between both cusps; the raphe is a fibrous ridge that extends from the commissure to the free edge of the two underdeveloped, conjoint cusps). Evidence: TAS. Frequency: Occasional (HP:0040283). (ORPHA:261537)
- Aortic valve stenosis (HP:0001650): The presence of a stenosis (narrowing) of the aortic valve. Evidence: TAS. Frequency: Occasional (HP:0040283). (ORPHA:261537)
- Coarctation of aorta (HP:0001680): Coarctation of the aorta is a narrowing or constriction of a segment of the aorta. Evidence: TAS. Frequency: Occasional (HP:0040283). (ORPHA:261537)
- Asplenia (HP:0001746): Absence (aplasia) of the spleen. Evidence: TAS. Frequency: Occasional (HP:0040283). (ORPHA:261537)
- Pes planus (HP:0001763): A foot where the longitudinal arch of the foot is in contact with the ground or floor when the individual is standing; or, in a patient lying supine, a foot where the arch is in contact with the surface of a flat board pressed against the sole of the foot by the examiner with a pressure similar to that expected from weight bearing; or, the height of the arch is reduced. Evidence: TAS. Frequency: Occasional (HP:0040283). (ORPHA:261537)
- Hallux valgus (HP:0001822): Lateral deviation of the great toe (i.e., in the direction of the little toe). Evidence: TAS. Frequency: Occasional (HP:0040283). (ORPHA:261537)
- Long hallux (HP:0001847): Increased length of the big toe. Evidence: TAS. Frequency: Occasional (HP:0040283). (ORPHA:261537)
- Calcaneovalgus deformity (HP:0001848): This is a postural deformity in which the foot is positioned up against the tibia. The heel (calcaneus) is positioned downward (that is, the ankle is flexed upward), and the heel is turned outward (valgus). Evidence: TAS. Frequency: Occasional (HP:0040283). (ORPHA:261537)
- Constipation (HP:0002019): Infrequent or difficult evacuation of feces. Evidence: TAS. Frequency: Occasional (HP:0040283). (ORPHA:261537)
- Pyloric stenosis (HP:0002021): Pyloric stenosis, also known as infantile hypertrophic pyloric stenosis, is an uncommon condition in infants characterized by abnormal thickening of the pylorus muscles in the stomach leading to gastric outlet obstruction. Clinically infants are well at birth. Then, at 3 to 6 weeks of age, the infants present with projectile vomiting, potentially leading to dehydration and weight loss. Evidence: TAS. Frequency: Occasional (HP:0040283). (ORPHA:261537)
- Inability to walk (HP:0002540): Incapability to ambulate. Evidence: TAS. Frequency: Occasional (HP:0040283). (ORPHA:261537)
- Episodic vomiting (HP:0002572): Paroxysmal, recurrent episodes of vomiting. Evidence: TAS. Frequency: Occasional (HP:0040283). (ORPHA:261537)
- Scoliosis (HP:0002650): The presence of an abnormal lateral curvature of the spine. Evidence: TAS. Frequency: Occasional (HP:0040283). (ORPHA:261537)
- Recurrent infections (HP:0002719): Increased susceptibility to infections as manifested by repeated bouts of infection. Evidence: TAS. Frequency: Occasional (HP:0040283). (ORPHA:261537)
- Delayed skeletal maturation (HP:0002750): A decreased rate of skeletal maturation. Delayed skeletal maturation can be diagnosed on the basis of an estimation of the bone age from radiographs of specific bones in the human body. Evidence: TAS. Frequency: Occasional (HP:0040283). (ORPHA:261537)
- Genu valgum (HP:0002857): The legs angle inward, such that the knees are close together and the ankles far apart. Evidence: TAS. Frequency: Occasional (HP:0040283). (ORPHA:261537)
- Bruxism (HP:0003763): Bruxism is characterized by the grinding of the teeth including the clenching of the jaw and typically occur during sleep. Evidence: TAS. Frequency: Occasional (HP:0040283). (ORPHA:261537)
- Decreased circulating immunoglobulin concentration (HP:0004313): An abnormally decreased level of immunoglobulin in blood. Evidence: TAS. Frequency: Occasional (HP:0040283). (ORPHA:261537)
- Abnormality of the pulmonary artery (HP:0004414): An abnormality of the pulmonary artery. Evidence: TAS. Frequency: Occasional (HP:0040283). (ORPHA:261537)
- Abnormal dental morphology (HP:0006482): An abnormality of the morphology of the tooth. Evidence: TAS. Frequency: Occasional (HP:0040283). (ORPHA:261537)
- Large basal ganglia (HP:0007048): Increased size of the basal ganglia. Evidence: TAS. Frequency: Occasional (HP:0040283). (ORPHA:261537)
- Impaired pain sensation (HP:0007328): Reduced ability to perceive painful stimuli. Evidence: TAS. Frequency: Occasional (HP:0040283). (ORPHA:261537)
- Ulnar deviation of the hand (HP:0009487): Divergence of the longitudinal axis of the hand at the wrist in a posterior (ulnar) direction (i.e., towards the little finger). Evidence: TAS. Frequency: Occasional (HP:0040283). (ORPHA:261537)
- Broad hallux (HP:0010055): Visible increase in width of the hallux without an increase in the dorso-ventral dimension. Evidence: TAS. Frequency: Occasional (HP:0040283). (ORPHA:261537)
- Long toe (HP:0010511): Toes that appear disproportionately long compared to the foot. Evidence: TAS. Frequency: Occasional (HP:0040283). (ORPHA:261537)
- Primary microcephaly (HP:0011451): Head circumference below 2 standard deviations below the mean for age and gender at birth. Evidence: TAS. Frequency: Occasional (HP:0040283). (ORPHA:261537)
- Camptodactyly (HP:0012385): The distal interphalangeal joint and/or the proximal interphalangeal joint of the fingers or toes cannot be extended to 180 degrees by either active or passive extension. Evidence: TAS. Frequency: Occasional (HP:0040283). (ORPHA:261537)
- Cerebral white matter hypoplasia (HP:0012430): Underdevelopment of the cerebral white matter. Evidence: TAS. Frequency: Occasional (HP:0040283). (ORPHA:261537)
- Focal hypointensity of cerebral white matter on MRI (HP:0040331). Evidence: TAS. Frequency: Occasional (HP:0040283). (ORPHA:261537)
- Hydrocele testis (HP:0000034): Accumulation of clear fluid in the between the layers of membrane (tunica vaginalis) surrounding the testis. Evidence: TAS. Frequency: Very rare (HP:0040284). (ORPHA:261537)
- Chordee (HP:0000041): A congenital anomaly of the penis characterized by ventral (i.e., downward), lateral, or ventrolateral curvature of the shaft and glans penis of more than 30 degrees. Evidence: TAS. Frequency: Very rare (HP:0040284). (ORPHA:261537)
- Bifid scrotum (HP:0000048): Midline indentation or cleft of the scrotum. Evidence: TAS. Frequency: Very rare (HP:0040284). (ORPHA:261537)
- Micropenis (HP:0000054): Abnormally small penis. At birth, the normal penis is about 3 cm (stretched length from pubic tubercle to tip of penis) with micropenis less than 2.0-2.5 cm. Evidence: TAS. Frequency: Very rare (HP:0040284). (ORPHA:261537)
- Cleft palate (HP:0000175): Cleft palate is a developmental defect of the palate resulting from a failure of fusion of the palatine processes and manifesting as a separation of the roof of the mouth (soft and hard palate). Evidence: TAS. Frequency: Very rare (HP:0040284). (ORPHA:261537)
- Bifid uvula (HP:0000193): Uvula separated into two parts most easily seen at the tip. Evidence: TAS. Frequency: Very rare (HP:0040284). (ORPHA:261537)
- Sensorineural hearing impairment (HP:0000407): A type of hearing impairment in one or both ears related to an abnormal functionality of the cochlear nerve. Evidence: TAS. Frequency: Very rare (HP:0040284). (ORPHA:261537)
- Septate vagina (HP:0001153): The presence of a vaginal septum, thereby creating a vaginal duplication. The septum is longitudinal in the majority of cases. Evidence: TAS. Frequency: Very rare (HP:0040284). (ORPHA:261537)
- Cerebellar vermis hypoplasia (HP:0001320): Underdevelopment of the vermis of cerebellum. Evidence: TAS. Frequency: Very rare (HP:0040284). (ORPHA:261537)
- Cerebellar hypoplasia (HP:0001321): Cerebellar hypoplasia is a descriptive term implying a cerebellum with a reduced volume, but a normal shape and is stable over time. Evidence: TAS. Frequency: Very rare (HP:0040284). (ORPHA:261537)
- Dysphagia (HP:0002015): Difficulty in swallowing. Evidence: TAS. Frequency: Very rare (HP:0040284). (ORPHA:261537)
- Polymicrogyria (HP:0002126): Polymicrogyria is a congenital malformation of the cerebral cortex characterized by abnormal cortical layering (lamination) and an excessive number of small gyri (folds). Evidence: TAS. Frequency: Very rare (HP:0040284). (ORPHA:261537)
- Agenesis of cerebellar vermis (HP:0002335): Congenital absence of the vermis of cerebellum. Evidence: TAS. Frequency: Very rare (HP:0040284). (ORPHA:261537)
- Poor speech (HP:0002465). Evidence: TAS. Frequency: Very rare (HP:0040284). (ORPHA:261537)
- Tracheal stenosis (HP:0002777). Evidence: TAS. Frequency: Very rare (HP:0040284). (ORPHA:261537)
- Pulmonary artery sling (HP:0004961): An anomalous origin of the left pulmonary artery, such that it arises from the posterior aspect of the right pulmonary artery and passes between the trachea and esophagus to reach the left hilum. Evidence: TAS. Frequency: Very rare (HP:0040284). (ORPHA:261537)
- Chiari type I malformation (HP:0007099): Arnold-Chiari type I malformation refers to a relatively mild degree of herniation of the posteroinferior region of the cerebellum (the cerebellar tonsils) into the cervical canal with little or no displacement of the fourth ventricle. It is characterized by one or both pointed (not rounded) cerebellar tonsils that project 5 mm below the foramen magnum, measured by a line drawn from the basion to the opisthion (McRae Line). Evidence: TAS. Frequency: Very rare (HP:0040284). (ORPHA:261537)
- Periventricular heterotopia (HP:0007165): A form of gray matter heterotopia were the mislocalized gray matter is typically located periventricularly, also sometimes called subependymal heterotopia. Periventricular means beside the ventricles. This is by far the most common location for heterotopia. Subependymal heterotopia present in a wide array of variations. There can be a small single node or a large number of nodes, can exist on either or both sides of the brain at any point along the higher ventricle margins, can be small or large, single or multiple, and can form a small node or a large wavy or curved mass. Evidence: TAS. Frequency: Very rare (HP:0040284). (ORPHA:261537)
- Right unicoronal synostosis (HP:0011317): Unicoronal synostosis affecting only the right coronal suture. Evidence: TAS. Frequency: Very rare (HP:0040284). (ORPHA:261537)
- Enlarged cerebellum (HP:0012081): An abnormally increased size of the cerebellum compared to other brain structures. Evidence: TAS. Frequency: Very rare (HP:0040284). (ORPHA:261537)
- Webbed penis (HP:0030264): Ventral skinfold extending from penis to scrotum. Evidence: TAS. Frequency: Very rare (HP:0040284). (ORPHA:261537)
- Cleft hard palate (HP:0410005). Evidence: TAS. Frequency: Very rare (HP:0040284). (ORPHA:261537)
- Submucous cleft of soft and hard palate (HP:0410031): Soft and hard-palate submucous clefts are characterized by bony defects in the midline of the soft and hard palate that are covered by the lining (ie mucous membrane) of the roof of the mouth. Evidence: TAS. Frequency: Very rare (HP:0040284). (ORPHA:261537)
These phenotypes are associated with the disease Mowat-Wilson syndrome due to monosomy 2q22 (ORPHA:261537).